- X-linked recessive inheritance (HP:0001419): A mode of inheritance that is observed for recessive traits related to a gene encoded on the X chromosome. In the context of medical genetics, X-linked recessive disorders manifest in males (who have one copy of the X chromosome and are thus hemizygotes), but generally not in female heterozygotes who have one mutant and one normal allele. Evidence: PCS. (PMID:11337751)
- Intellectual disability (HP:0001249): The term intellectual disability or intellectual developmental disorder is used to describe significantly sub-average intellectual and adaptive functioning based on clinical assessment and as measured by individually administered, appropriately normed, standardized and validated tests of intellectual functioning and adaptive behavior, with onset during the developmental period from infancy through adolescence. Evidence: PCS. Frequency: 8/8. (PMID:11337751)
These phenotypes are associated with the disease intellectual disability, X-linked 53 (OMIM:300324).